- Wide mouth (HP:0000154): Distance between the oral commissures more than 2 SD above the mean. Alternatively, an apparently increased width of the oral aperture (subjective). Evidence: TAS. Frequency: Very frequent (HP:0040281). (ORPHA:1394)
- Brachycephaly (HP:0000248): An abnormality of skull shape characterized by a decreased anterior-posterior diameter. That is, a cephalic index greater than 81%. Alternatively, an apparently shortened anteroposterior dimension (length) of the head compared to width. Evidence: TAS. Frequency: Very frequent (HP:0040281). (ORPHA:1394)
- Broad philtrum (HP:0000289): Distance between the philtral ridges, measured just above the vermilion border, more than 2 standard deviations above the mean, or alternatively, an apparently increased distance between the ridges of the philtrum. Evidence: TAS. Frequency: Very frequent (HP:0040281). (ORPHA:1394)
- Hypertelorism (HP:0000316): Interpupillary distance more than 2 SD above the mean (alternatively, the appearance of an increased interpupillary distance or widely spaced eyes). Evidence: TAS. Frequency: Very frequent (HP:0040281). (ORPHA:1394)
- Wide nose (HP:0000445): Interalar distance more than two standard deviations above the mean for age, i.e., an apparently increased width of the nasal base and alae. Evidence: TAS. Frequency: Very frequent (HP:0040281). (ORPHA:1394)
- Short neck (HP:0000470): Diminished length of the neck. Evidence: TAS. Frequency: Very frequent (HP:0040281). (ORPHA:1394)
- Thick eyebrow (HP:0000574): Increased density/number and/or increased diameter of eyebrow hairs. Evidence: TAS. Frequency: Very frequent (HP:0040281). (ORPHA:1394)
- Narrow chest (HP:0000774): Reduced width of the chest from side to side, associated with a reduced distance from the sternal notch to the tip of the shoulder. Evidence: TAS. Frequency: Very frequent (HP:0040281). (ORPHA:1394)
- Bifid ribs (HP:0000892): A bifid rib refers to cleavage of the sternal end of a rib, usually unilateral. Bifid ribs are usually asymptomatic, and are often discovered incidentally by chest x-ray. Evidence: TAS. Frequency: Very frequent (HP:0040281). (ORPHA:1394)
- Rib fusion (HP:0000902): Complete or partial merging of adjacent ribs. Evidence: TAS. Frequency: Very frequent (HP:0040281). (ORPHA:1394)
- Intellectual disability (HP:0001249): The term intellectual disability or intellectual developmental disorder is used to describe significantly sub-average intellectual and adaptive functioning based on clinical assessment and as measured by individually administered, appropriately normed, standardized and validated tests of intellectual functioning and adaptive behavior, with onset during the developmental period from infancy through adolescence. Evidence: TAS. Frequency: Very frequent (HP:0040281). (ORPHA:1394)
- Hypoplasia of the corpus callosum (HP:0002079): Underdevelopment of the corpus callosum. Evidence: TAS. Frequency: Very frequent (HP:0040281). (ORPHA:1394)
- Hemivertebrae (HP:0002937): Absence of one half of the vertebral body. Evidence: TAS. Frequency: Very frequent (HP:0040281). (ORPHA:1394)
- Midface retrusion (HP:0011800): Posterior positions and/or vertical shortening of the infraorbital and perialar regions, or increased concavity of the face and/or reduced nasolabial angle. Evidence: TAS. Frequency: Very frequent (HP:0040281). (ORPHA:1394)
- Macrocephaly (HP:0000256): Occipitofrontal (head) circumference greater than 97th centile compared to appropriate, age matched, sex-matched normal standards. Alternatively, a apparently increased size of the cranium. Evidence: TAS. Frequency: Frequent (HP:0040282). (ORPHA:1394)
- Epicanthus (HP:0000286): A fold of skin starting above the medial aspect of the upper eyelid and arching downward to cover, pass in front of and lateral to the medial canthus. Evidence: TAS. Frequency: Frequent (HP:0040282). (ORPHA:1394)
- Strabismus (HP:0000486): A misalignment of the eyes so that the visual axes deviate from bifoveal fixation. The classification of strabismus may be based on a number of features including the relative position of the eyes, whether the deviation is latent or manifest, intermittent or constant, concomitant or otherwise and according to the age of onset and the relevance of any associated refractive error. Evidence: TAS. Frequency: Frequent (HP:0040282). (ORPHA:1394)
- Downslanted palpebral fissures (HP:0000494): The palpebral fissure inclination is more than two standard deviations below the mean. Evidence: TAS. Frequency: Frequent (HP:0040282). (ORPHA:1394)
- Synophrys (HP:0000664): Meeting of the medial eyebrows in the midline. Evidence: TAS. Frequency: Frequent (HP:0040282). (ORPHA:1394)
- Sprengel anomaly (HP:0000912): A congenital skeletal deformity characterized by the elevation of one scapula (thus, one scapula is located superior to the other). Evidence: TAS. Frequency: Frequent (HP:0040282). (ORPHA:1394)
- Cerebellar vermis hypoplasia (HP:0001320): Underdevelopment of the vermis of cerebellum. Evidence: TAS. Frequency: Frequent (HP:0040282). (ORPHA:1394)
- Polyhydramnios (HP:0001561): The presence of excess amniotic fluid in the uterus during pregnancy. Evidence: TAS. Frequency: Frequent (HP:0040282). (ORPHA:1394)
- Ventriculomegaly (HP:0002119): An increase in size of the ventricular system of the brain. Evidence: TAS. Frequency: Frequent (HP:0040282). (ORPHA:1394)
- Cerebral cortical atrophy (HP:0002120): Atrophy of the cortex of the cerebrum. Evidence: TAS. Frequency: Frequent (HP:0040282). (ORPHA:1394)
- Low posterior hairline (HP:0002162): Hair on the neck extends more inferiorly than usual. Evidence: TAS. Frequency: Frequent (HP:0040282). (ORPHA:1394)
- Coarse hair (HP:0002208): Hair shafts are rough in texture. Evidence: TAS. Frequency: Frequent (HP:0040282). (ORPHA:1394)
- Scoliosis (HP:0002650): The presence of an abnormal lateral curvature of the spine. Evidence: TAS. Frequency: Frequent (HP:0040282). (ORPHA:1394)
- Short nose (HP:0003196): Distance from nasion to subnasale more than two standard deviations below the mean, or alternatively, an apparently decreased length from the nasal root to the nasal tip. Evidence: TAS. Frequency: Frequent (HP:0040282). (ORPHA:1394)
- Vertebral segmentation defect (HP:0003422): An abnormality related to a defect of vertebral separation during development. Evidence: TAS. Frequency: Frequent (HP:0040282). (ORPHA:1394)
- Short stature (HP:0004322): A height below that which is expected according to age and gender norms. Although there is no universally accepted definition of short stature, many refer to "short stature" as height more than 2 standard deviations below the mean for age and gender (or below the 3rd percentile for age and gender dependent norms). Evidence: TAS. Frequency: Frequent (HP:0040282). (ORPHA:1394)
- Abnormal hair pattern (HP:0010720): An abnormality of the distribution of hair growth. Evidence: TAS. Frequency: Frequent (HP:0040282). (ORPHA:1394)
- Hernia (HP:0100790). Evidence: TAS. Frequency: Frequent (HP:0040282). (ORPHA:1394)
- Cleft palate (HP:0000175): Cleft palate is a developmental defect of the palate resulting from a failure of fusion of the palatine processes and manifesting as a separation of the roof of the mouth (soft and hard palate). Evidence: TAS. Frequency: Occasional (HP:0040283). (ORPHA:1394)
- Cleft upper lip (HP:0000204): A gap or groove in the upper lip. This is a congenital defect resulting from nonfusion of tissues of the lip during embryonal development. Evidence: TAS. Frequency: Occasional (HP:0040283). (ORPHA:1394)
- Posteriorly rotated ears (HP:0000358): A type of abnormal location of the ears in which the position of the ears is characterized by posterior rotation (the superior part of the ears is rotated towards the back of the head, and the inferior part of the ears towards the front). Evidence: TAS. Frequency: Very frequent (HP:0040281). (ORPHA:1394)
These phenotypes are associated with the disease Cerebrofaciothoracic dysplasia (ORPHA:1394).